- Nephropathy (HP:0000112): A nonspecific term referring to disease or damage of the kidneys. Evidence: IEA. (OMIM:124100)
This phenotype is associated with the disease Balkan nephropathy (OMIM:124100).